Phenotypes associated with the disease Dysosteosclerosis (ORPHA:1782):
- Macrocephaly (HP:0000256): Occipitofrontal (head) circumference greater than 97th centile compared to appropriate, age matched, sex-matched normal standards. Alternatively, a apparently increased size of the cranium. Evidence: TAS. Frequency: Very frequent (HP:0040281). (ORPHA:1782)
- Hypertelorism (HP:0000316): Interpupillary distance more than 2 SD above the mean (alternatively, the appearance of an increased interpupillary distance or widely spaced eyes). Evidence: TAS. Frequency: Very frequent (HP:0040281). (ORPHA:1782)
- Hearing impairment (HP:0000365): A decreased magnitude of the sensory perception of sound. Evidence: TAS. Frequency: Very frequent (HP:0040281). (ORPHA:1782)
- Nystagmus (HP:0000639): Rhythmic, involuntary oscillations of one or both eyes related to abnormality in fixation, conjugate gaze, or vestibular mechanisms. Evidence: TAS. Frequency: Very frequent (HP:0040281). (ORPHA:1782)
- Optic atrophy (HP:0000648): Atrophy of the optic nerve. Optic atrophy results from the death of the retinal ganglion cell axons that comprise the optic nerve and manifesting as a pale optic nerve on fundoscopy. Evidence: TAS. Frequency: Very frequent (HP:0040281). (ORPHA:1782)
- Abnormal dental enamel morphology (HP:0000682): An abnormality of the dental enamel. Evidence: TAS. Frequency: Very frequent (HP:0040281). (ORPHA:1782)
- Delayed eruption of teeth (HP:0000684): Delayed tooth eruption, which can be defined as tooth eruption more than 2 SD beyond the mean eruption age. Evidence: TAS. Frequency: Very frequent (HP:0040281). (ORPHA:1782)
- Platyspondyly (HP:0000926): A flattened vertebral body shape with reduced distance between the vertebral endplates. Evidence: TAS. Frequency: Very frequent (HP:0040281). (ORPHA:1782)
- Abnormal metaphysis morphology (HP:0000944): An abnormality of one or more metaphysis, i.e., of the somewhat wider portion of a long bone that is adjacent to the epiphyseal growth plate and grows during childhood. Evidence: TAS. Frequency: Very frequent (HP:0040281). (ORPHA:1782)
- Intellectual disability (HP:0001249): The term intellectual disability or intellectual developmental disorder is used to describe significantly sub-average intellectual and adaptive functioning based on clinical assessment and as measured by individually administered, appropriately normed, standardized and validated tests of intellectual functioning and adaptive behavior, with onset during the developmental period from infancy through adolescence. Evidence: TAS. Frequency: Very frequent (HP:0040281). (ORPHA:1782)
- Abnormal cranial nerve morphology (HP:0001291): Structural abnormality affecting one or more of the cranial nerves, which emerge directly from the brain stem. Evidence: TAS. Frequency: Very frequent (HP:0040281). (ORPHA:1782)
- Ventricular septal defect (HP:0001629): A hole between the two bottom chambers (ventricles) of the heart. The defect is centered around the most superior aspect of the ventricular septum. Evidence: TAS. Frequency: Very frequent (HP:0040281). (ORPHA:1782)
- Developmental regression (HP:0002376): Loss of developmental skills, as manifested by loss of developmental milestones. Evidence: TAS. Frequency: Very frequent (HP:0040281). (ORPHA:1782)
- Cerebral calcification (HP:0002514): The presence of calcium deposition within the cerebrum. Evidence: TAS. Frequency: Very frequent (HP:0040281). (ORPHA:1782)
- Recurrent fractures (HP:0002757): The repeated occurrence of bone fractures (implying an abnormally increased tendency for fracture). Evidence: TAS. Frequency: Very frequent (HP:0040281). (ORPHA:1782)
- Irregular vertebral endplates (HP:0003301): An irregular surface of the vertebral end plates, which are normally relatively smooth. Evidence: TAS. Frequency: Very frequent (HP:0040281). (ORPHA:1782)
- Short stature (HP:0004322): A height below that which is expected according to age and gender norms. Although there is no universally accepted definition of short stature, many refer to "short stature" as height more than 2 standard deviations below the mean for age and gender (or below the 3rd percentile for age and gender dependent norms). Evidence: TAS. Frequency: Very frequent (HP:0040281). (ORPHA:1782)
- Craniofacial hyperostosis (HP:0004493): Excessive growth of the craniofacial bones. Evidence: TAS. Frequency: Very frequent (HP:0040281). (ORPHA:1782)
- Aplasia/Hypoplasia of the skin (HP:0008065). Evidence: TAS. Frequency: Frequent (HP:0040282). (ORPHA:1782)
- Hypoplastic vertebral bodies (HP:0008479). Evidence: TAS. Frequency: Very frequent (HP:0040281). (ORPHA:1782)
- Increased bone mineral density (HP:0011001): An abnormal increase of bone mineral density, that is, of the amount of matter per cubic centimeter of bones which is often referred to as osteosclerosis. Osteosclerosis can be detected on radiological examination as an increased whiteness (density) of affected bones. Evidence: TAS. Frequency: Very frequent (HP:0040281). (ORPHA:1782)
- Coarse metaphyseal trabecularization (HP:0100670): Coarse appearance of the components of the network of osseous tissue that makes up the cancellous structure of a bone, i.e., thickening of the (usually fine) white lines that are produced by trabeculae in radiograms. Evidence: TAS. Frequency: Very frequent (HP:0040281). (ORPHA:1782)